- Cleft palate (HP:0000175): Cleft palate is a developmental defect of the palate resulting from a failure of fusion of the palatine processes and manifesting as a separation of the roof of the mouth (soft and hard palate). Evidence: TAS. Frequency: Very frequent (HP:0040281). (ORPHA:916)
- Trismus (HP:0000211): Limitation in the ability to open the mouth. Evidence: TAS. Frequency: Very frequent (HP:0040281). (ORPHA:916)
- Abnormal pinna morphology (HP:0000377): An abnormality of the pinna, which is also referred to as the auricle or external ear. Evidence: TAS. Frequency: Very frequent (HP:0040281). (ORPHA:916)
- Strabismus (HP:0000486): A misalignment of the eyes so that the visual axes deviate from bifoveal fixation. The classification of strabismus may be based on a number of features including the relative position of the eyes, whether the deviation is latent or manifest, intermittent or constant, concomitant or otherwise and according to the age of onset and the relevance of any associated refractive error. Evidence: TAS. Frequency: Occasional (HP:0040283). (ORPHA:916)
- Slender finger (HP:0001238): Fingers that are disproportionately narrow (reduced girth) for the hand/foot size or build of the individual. Evidence: TAS. Frequency: Occasional (HP:0040283). (ORPHA:916)
- Dandy-Walker malformation (HP:0001305): A congenital brain malformation typically characterized by incomplete formation of the cerebellar vermis, dilation of the fourth ventricle, and enlargement of the posterior fossa. In layman's terms, Dandy Walker malformation is a cyst in the cerebellum (typically symmetrical) that is involved with the fourth ventricle. This may interfere with the ability to drain cerebrospinal fluid from the brain, resulting in hydrocephalus. Dandy Walker cysts are formed during early embryonic development, while the brain forms. The cyst in the cerebellum typically has several blood vessels running through it connecting to the brain, thereby prohibiting surgical removal. Evidence: TAS. Frequency: Very frequent (HP:0040281). (ORPHA:916)
- Joint stiffness (HP:0001387): Joint stiffness is a perceived sensation of tightness in a joint or joints when attempting to move them after a period of inactivity. Joint stiffness typically subsides over time. Evidence: TAS. Frequency: Very frequent (HP:0040281). (ORPHA:916)
- Talipes equinovarus (HP:0001762): Talipes equinovarus (also called clubfoot) typically has four main components: inversion and adduction of the forefoot; inversion of the heel and hindfoot; equinus (limitation of extension) of the ankle and subtalar joint; and internal rotation of the leg. Evidence: TAS. Frequency: Frequent (HP:0040282). (ORPHA:916)
- Scoliosis (HP:0002650): The presence of an abnormal lateral curvature of the spine. Evidence: TAS. Frequency: Very frequent (HP:0040281). (ORPHA:916)
- Neoplasm (HP:0002664): An organ or organ-system abnormality that consists of uncontrolled autonomous cell-proliferation which can occur in any part of the body as a benign or malignant neoplasm (tumor). Evidence: TAS. Frequency: Occasional (HP:0040283). (ORPHA:916)
- Multiple joint contractures (HP:0002828). Evidence: TAS. Frequency: Very frequent (HP:0040281). (ORPHA:916)
- Abnormal hip bone morphology (HP:0003272): An abnormality of the hip bone. Evidence: TAS. Frequency: Very frequent (HP:0040281). (ORPHA:916)
- Aplasia/Hypoplasia of the radius (HP:0006501): A small/hypoplastic or absent/aplastic radius. Evidence: TAS. Frequency: Frequent (HP:0040282). (ORPHA:916)
- Camptodactyly of finger (HP:0100490): The distal interphalangeal joint and/or the proximal interphalangeal joint of the fingers cannot be extended to 180 degrees by either active or passive extension. Evidence: TAS. Frequency: Very frequent (HP:0040281). (ORPHA:916)
These phenotypes are associated with the disease Aase-Smith syndrome type 1 (ORPHA:916).